Phenotypes associated with the disease 5q35 microduplication syndrome (ORPHA:228415):
- Microcephaly (HP:0000252): Head circumference below 2 standard deviations below the mean for age and gender. Evidence: TAS. Frequency: Very frequent (HP:0040281). (ORPHA:228415)
- Myopia (HP:0000545): An abnormality of refraction characterized by the ability to see objects nearby clearly, while objects in the distance appear blurry. Evidence: TAS. Frequency: Frequent (HP:0040282). (ORPHA:228415)
- Atypical behavior (HP:0000708): Atypical behavior is an abnormality in a person's actions that can be controlled or modulated by the will of the individual. While abnormal behaviors can be difficult to control, they are distinct from other abnormal actions that cannot be affected by the individual's will. Evidence: TAS. Frequency: Frequent (HP:0040282). (ORPHA:228415)
- Intellectual disability (HP:0001249): The term intellectual disability or intellectual developmental disorder is used to describe significantly sub-average intellectual and adaptive functioning based on clinical assessment and as measured by individually administered, appropriately normed, standardized and validated tests of intellectual functioning and adaptive behavior, with onset during the developmental period from infancy through adolescence. Evidence: TAS. Frequency: Very frequent (HP:0040281). (ORPHA:228415)
- Seizure (HP:0001250): A seizure is an intermittent abnormality of nervous system physiology characterized by a transient occurrence of signs and/or symptoms due to abnormal excessive or synchronous neuronal activity in the brain. Evidence: TAS. Frequency: Occasional (HP:0040283). (ORPHA:228415)
- Specific learning disability (HP:0001328): Impairment of certain skills such as reading or writing, coordination, self-control, or attention that interfere with the ability to learn. The impairment is not related to a global deficiency of intelligence. Evidence: TAS. Frequency: Very frequent (HP:0040281). (ORPHA:228415)
- Growth delay (HP:0001510): A deficiency or slowing down of growth pre- and postnatally. Evidence: TAS. Frequency: Very frequent (HP:0040281). (ORPHA:228415)
- Delayed skeletal maturation (HP:0002750): A decreased rate of skeletal maturation. Delayed skeletal maturation can be diagnosed on the basis of an estimation of the bone age from radiographs of specific bones in the human body. Evidence: TAS. Frequency: Frequent (HP:0040282). (ORPHA:228415)
- Short stature (HP:0004322): A height below that which is expected according to age and gender norms. Although there is no universally accepted definition of short stature, many refer to "short stature" as height more than 2 standard deviations below the mean for age and gender (or below the 3rd percentile for age and gender dependent norms). Evidence: TAS. Frequency: Very frequent (HP:0040281). (ORPHA:228415)